Phenotypes associated with the disease Epiphyseal stippling-osteoclastic hyperplasia syndrome (ORPHA:1952):
- Hypotelorism (HP:0000601): Interpupillary distance less than 2 SD below the mean (alternatively, the appearance of an decreased interpupillary distance or closely spaced eyes). Evidence: TAS. Frequency: Very frequent (HP:0040281). (ORPHA:1952)
- Patent ductus arteriosus (HP:0001643): In utero, the ductus arteriosus (DA) serves to divert ventricular output away from the lungs and toward the placenta by connecting the main pulmonary artery to the descending aorta. A patent ductus arteriosus (PDA) in the first 3 days of life is a physiologic shunt in healthy term and preterm newborn infants, and normally is substantially closed within about 24 hours after bith and completely closed after about three weeks. Failure of physiologcal closure is referred to a persistent or patent ductus arteriosus (PDA). Depending on the degree of left-to-right shunting, PDA can have clinical consequences. Evidence: TAS. Frequency: Very frequent (HP:0040281). (ORPHA:1952)
- Abnormal calvaria morphology (HP:0002683): Abnormality of the morphology (structure) of the calvaria (skullcap), that is, of that part of the skull that is made up of the superior portions of the frontal bone, occipital bone, and parietal bones and covers the cranial cavity that contains the brain. Evidence: TAS. Frequency: Very frequent (HP:0040281). (ORPHA:1952)
- Genu varum (HP:0002970): A positional abnormality marked by outward bowing of the legs in which the knees stay wide apart when a person stands with the feet and ankles together. Evidence: TAS. Frequency: Very frequent (HP:0040281). (ORPHA:1952)
- Coronal cleft vertebrae (HP:0003417): Frontal schisis (cleft or cleavage) of vertebral bodies. Evidence: TAS. Frequency: Very frequent (HP:0040281). (ORPHA:1952)
- Lethal skeletal dysplasia (HP:0005716). Evidence: TAS. Frequency: Very frequent (HP:0040281). (ORPHA:1952)
- Bowing of the long bones (HP:0006487): A bending or abnormal curvature of a long bone. Evidence: TAS. Frequency: Very frequent (HP:0040281). (ORPHA:1952)
- Epiphyseal stippling (HP:0010655): The presence of abnormal punctate (speckled, dot-like) calcifications in one or more epiphyses. Evidence: TAS. Frequency: Very frequent (HP:0040281). (ORPHA:1952)
- Abnormal bone ossification (HP:0011849): Any anomaly in the formation of bone or of a bony substance, or the conversion of fibrous tissue or of cartilage into bone or a bony substance. Evidence: TAS. Frequency: Very frequent (HP:0040281). (ORPHA:1952)
- Coarse metaphyseal trabecularization (HP:0100670): Coarse appearance of the components of the network of osseous tissue that makes up the cancellous structure of a bone, i.e., thickening of the (usually fine) white lines that are produced by trabeculae in radiograms. Evidence: TAS. Frequency: Very frequent (HP:0040281). (ORPHA:1952)